Phenotypes associated with the disease transcobalamin I deficiency (OMIM:193090):
- Paresthesia (HP:0003401): Abnormal sensations such as tingling, pricking, or numbness of the skin with no apparent physical cause. Evidence: IEA. (OMIM:193090)
- Abnormality of metabolism/homeostasis (HP:0001939). Evidence: IEA. (OMIM:193090)
- Autosomal recessive inheritance (HP:0000007): A mode of inheritance that is observed for traits related to a gene encoded on one of the autosomes (i.e., the human chromosomes 1-22) in which a trait manifests in individuals with two pathogenic alleles, either homozygotes (two copies of the same mutant allele) or compound heterozygotes (whereby each copy of a gene has a distinct mutant allele). Evidence: TAS. (OMIM:193090)
- Autosomal dominant inheritance (HP:0000006): A mode of inheritance that is observed for traits related to a gene encoded on one of the autosomes (i.e., the human chromosomes 1-22) in which a trait manifests in heterozygotes. In the context of medical genetics, an autosomal dominant disorder is caused when a single copy of the mutant allele is present. Males and females are affected equally, and can both transmit the disorder with a risk of 50% for each child of inheriting the mutant allele. Evidence: IEA. (OMIM:193090)
- Diminished deep tendon reflex (HP:0001315): A reduction (hyporeflexia) or complete absence (areflexia) of the involuntary muscle contraction normally elicited by a reflex stimulus, such as tapping a deep tendon. Evidence: IEA. (OMIM:193090)